- Tics (HP:0100033): Repeated, individually recognizable, intermittent movements or movement fragments that are almost always briefly suppressible and are usually associated with awareness of an urge to perform the movement. Evidence: TAS. Frequency: Occasional (HP:0040283). (ORPHA:8)
- Abnormal emotional state (HP:0100851): A disturbance in the experience or expression of emotion, characterized by alterations in valence, intensity, frequency, or duration. It may also involve emotional responses that are mismatched, exaggerated, or incongruent relative to internal expectations or external contextual stimuli, such as experiencing negative affect in response to neutral or positive events. Evidence: TAS. Frequency: Occasional (HP:0040283). (ORPHA:8)
- Obsessive-compulsive trait (HP:0008770): The presence of one or more obsessive-compulsive personality traits. Obsessions refer to persistent intrusive thoughts, and compulsions to intrusive behaviors, which the affected person experiences as involuntary, senseless, or repugnant. Evidence: TAS. Frequency: Very rare (HP:0040284). (ORPHA:8)
- Reduced social responsiveness (HP:0012760): A reduced ability to participate in the back-and-forth flow of social interaction appropriate to culture and developmental level, which is normally characterized by an influence of the behavior of one person on the behavior of another person. This results in difficulty interacting with others through emotional, physical, or verbal communication. Evidence: TAS. Frequency: Frequent (HP:0040282). (ORPHA:8)
- Tall stature (HP:0000098): A height above that which is expected according to age and gender norms. Evidence: TAS. Frequency: Very frequent (HP:0040281). (ORPHA:8)
- Malar flattening (HP:0000272): Underdevelopment of the malar prominence of the jugal bone (zygomatic bone in mammals), appreciated in profile, frontal view, and/or by palpation. Evidence: TAS. Frequency: Very frequent (HP:0040281). (ORPHA:8)
- Low-set ears (HP:0000369): Upper insertion of the ear to the scalp below an imaginary horizontal line drawn between the inner canthi of the eye and extending posteriorly to the ear. Evidence: TAS. Frequency: Very frequent (HP:0040281). (ORPHA:8)
- Delayed speech and language development (HP:0000750): A degree of language development that is significantly below the norm for a child of a specified age. Evidence: TAS. Frequency: Very frequent (HP:0040281). (ORPHA:8)
- Motor delay (HP:0001270): A type of Developmental delay characterized by a delay in acquiring motor skills. Evidence: TAS. Frequency: Very frequent (HP:0040281). (ORPHA:8)
- Macrocephaly (HP:0000256): Occipitofrontal (head) circumference greater than 97th centile compared to appropriate, age matched, sex-matched normal standards. Alternatively, a apparently increased size of the cranium. Evidence: TAS. Frequency: Frequent (HP:0040282). (ORPHA:8)
- Hypertelorism (HP:0000316): Interpupillary distance more than 2 SD above the mean (alternatively, the appearance of an increased interpupillary distance or widely spaced eyes). Evidence: TAS. Frequency: Frequent (HP:0040282). (ORPHA:8)
- Atypical behavior (HP:0000708): Atypical behavior is an abnormality in a person's actions that can be controlled or modulated by the will of the individual. While abnormal behaviors can be difficult to control, they are distinct from other abnormal actions that cannot be affected by the individual's will. Evidence: TAS. Frequency: Frequent (HP:0040282). (ORPHA:8)
- Hyperactivity (HP:0000752): Hyperactivity is a condition characterized by constant and unusually high levels of activity, even in situations where it is deemed inappropriate. Evidence: TAS. Frequency: Frequent (HP:0040282). (ORPHA:8)
- Enuresis (HP:0000805): Lack of the ability to control the urinary bladder leading to involuntary urination at an age where control of the bladder should already be possible. Evidence: TAS. Frequency: Frequent (HP:0040282). (ORPHA:8)
- Intellectual disability (HP:0001249): The term intellectual disability or intellectual developmental disorder is used to describe significantly sub-average intellectual and adaptive functioning based on clinical assessment and as measured by individually administered, appropriately normed, standardized and validated tests of intellectual functioning and adaptive behavior, with onset during the developmental period from infancy through adolescence. Evidence: TAS. Frequency: Frequent (HP:0040282). (ORPHA:8)
- Neonatal hypotonia (HP:0001319): Muscular hypotonia (abnormally low muscle tone) manifesting in the neonatal period. Evidence: TAS. Frequency: Frequent (HP:0040282). (ORPHA:8)
- Specific learning disability (HP:0001328): Impairment of certain skills such as reading or writing, coordination, self-control, or attention that interfere with the ability to learn. The impairment is not related to a global deficiency of intelligence. Evidence: TAS. Frequency: Frequent (HP:0040282). (ORPHA:8)
- Tremor (HP:0001337): An unintentional, oscillating to-and-fro muscle movement about a joint axis. Evidence: TAS. Frequency: Frequent (HP:0040282). (ORPHA:8)
- Pes planus (HP:0001763): A foot where the longitudinal arch of the foot is in contact with the ground or floor when the individual is standing; or, in a patient lying supine, a foot where the arch is in contact with the surface of a flat board pressed against the sole of the foot by the examiner with a pressure similar to that expected from weight bearing; or, the height of the arch is reduced. Evidence: TAS. Frequency: Frequent (HP:0040282). (ORPHA:8)
- Asthma (HP:0002099): Asthma is characterized by increased responsiveness of the tracheobronchial tree to multiple stimuli, leading to narrowing of the air passages with resultant dyspnea, cough, and wheezing. Evidence: TAS. Frequency: Frequent (HP:0040282). (ORPHA:8)
- Attention deficit hyperactivity disorder (HP:0007018): Attention deficit hyperactivity disorder (ADHD) manifests at age 2-3 years or by first grade at the latest. The main symptoms are distractibility, impulsivity, hyperactivity, and often trouble organizing tasks and projects, difficulty going to sleep, and social problems from being aggressive, loud, or impatient. Evidence: TAS. Frequency: Frequent (HP:0040282). (ORPHA:8)
- Early-onset non-progressive night blindness (HP:0007642): A usually nonprogressive (i.e., stationary) form of night blindness with early (presumed to be congenital) onset. Evidence: TAS. Frequency: Frequent (HP:0040282). (ORPHA:8)
- Finger clinodactyly (HP:0040019). Evidence: TAS. Frequency: Frequent (HP:0040282). (ORPHA:8)
- Impulsivity (HP:0100710): Acting on the spur of the moment or on a momentary basis without consideration of outcomes; having difficulty establishing or following plans; experiencing a sense of urgency and engaging in behavior that is uninhibited, cannot be inhibited, and is uncontrolled. The possibility of repression is inconceivable. Evidence: TAS. Frequency: Frequent (HP:0040282). (ORPHA:8)
- Azoospermia (HP:0000027): Absence of any measurable level of sperm,whereby spermatozoa cannot be observed even after centrifugation of the semen pellet. Evidence: TAS. Frequency: Occasional (HP:0040283). (ORPHA:8)
- Cryptorchidism (HP:0000028): Testis in inguinal canal. That is, absence of one or both testes from the scrotum owing to failure of the testis or testes to descend through the inguinal canal to the scrotum. Evidence: TAS. Frequency: Occasional (HP:0040283). (ORPHA:8)
- Hypospadias (HP:0000047): Abnormal position of urethral meatus on the ventral penile shaft (underside) characterized by displacement of the urethral meatus from the tip of the glans penis to the ventral surface of the penis, scrotum, or perineum. Evidence: TAS. Frequency: Occasional (HP:0040283). (ORPHA:8)
- Macroorchidism (HP:0000053): The presence of abnormally large testes. Evidence: TAS. Frequency: Occasional (HP:0040283). (ORPHA:8)
- Micropenis (HP:0000054): Abnormally small penis. At birth, the normal penis is about 3 cm (stretched length from pubic tubercle to tip of penis) with micropenis less than 2.0-2.5 cm. Evidence: TAS. Frequency: Occasional (HP:0040283). (ORPHA:8)
- Hydrocephalus (HP:0000238): Hydrocephalus is an active distension of the ventricular system of the brain resulting from inadequate passage of CSF from its point of production within the cerebral ventricles to its point of absorption into the systemic circulation. Evidence: TAS. Frequency: Occasional (HP:0040283). (ORPHA:8)
- Mandibular prognathia (HP:0000303): Abnormal prominence of the chin related to increased length of the mandible. Evidence: TAS. Frequency: Occasional (HP:0040283). (ORPHA:8)
- Autistic behavior (HP:0000729): Persistent deficits in social interaction and communication and interaction as well as a markedly restricted repertoire of activity and interest as well as repetitive patterns of behavior. Evidence: TAS. Frequency: Occasional (HP:0040283). (ORPHA:8)
- Anxiety (HP:0000739): Intense feelings of nervousness, tension, or panic often arise in response to interpersonal stresses. There is worry about the negative effects of past unpleasant experiences and future negative possibilities. Individuals may feel fearful, apprehensive, or threatened by uncertainty, and they may also have fears of falling apart or losing control. Evidence: TAS. Frequency: Occasional (HP:0040283). (ORPHA:8)
- Oligozoospermia (HP:0000798): Reduced count of spermatozoa in the semen, defined as a sperm count below 20 million per milliliter semen. Evidence: TAS. Frequency: Occasional (HP:0040283). (ORPHA:8)
- Increased circulating gonadotropin level (HP:0000837): Overproduction of gonadotropins (FSH, LH) by the anterior pituitary gland. Evidence: TAS. Frequency: Occasional (HP:0040283). (ORPHA:8)
- Seizure (HP:0001250): A seizure is an intermittent abnormality of nervous system physiology characterized by a transient occurrence of signs and/or symptoms due to abnormal excessive or synchronous neuronal activity in the brain. Evidence: TAS. Frequency: Occasional (HP:0040283). (ORPHA:8)
- Macrodontia (HP:0001572): Increased size of the teeth, which can be defined as a mesiodistal tooth diameter (width) more than 2 SD above mean for age. Alternatively, an apparently increased maximum width of the tooth. Evidence: TAS. Frequency: Occasional (HP:0040283). (ORPHA:8)
- Dysgenesis of the cerebellar vermis (HP:0002195): Defective development of the vermis of cerebellum. Evidence: TAS. Frequency: Occasional (HP:0040283). (ORPHA:8)
- Abnormal brainstem morphology (HP:0002363): An anomaly of the brainstem. Evidence: TAS. Frequency: Occasional (HP:0040283). (ORPHA:8)
- Male infertility (HP:0003251). Evidence: TAS. Frequency: Occasional (HP:0040283). (ORPHA:8)
- Cerebellar dysplasia (HP:0007033): Cerebellar dysplasia (abnormal growth or development) is defined by abnormal cerebellar foliation, white matter arborization, and gray-white matter junction. Cerebellar dysplasia is a neuroimaging finding that describes abnormalities of both the cerebellar cortex and white matter and is associated with variable neurodevelopmental outcome. Dysplasia may globally involve the cerebellum or affect only one cerebellar hemisphere. In addition, cerebellar dysplasia may be associated with cortical/subcortical cysts. Evidence: TAS. Frequency: Occasional (HP:0040283). (ORPHA:8)
- Oppositional defiant disorder (HP:0010865): An enduring pattern of uncooperative, defiant, and hostile behavior towards authority figures that does not involve major antisocial violations, is not accounted for by the child's developmental stage, and results in significant functional impairment. A certain level of oppositional behavior is common in children and adolescents. Evidence: TAS. Frequency: Occasional (HP:0040283). (ORPHA:8)
- Varicocele (HP:0012871): A varicocele is a widening of the veins along the spermatic cord, leading to enlarged, twisted veins in the scrotum, and manifested clinically by a painless testicle lump, scrotal swelling, or bulge in the scrotum. Evidence: TAS. Frequency: Occasional (HP:0040283). (ORPHA:8)
- Increased serum testosterone level (HP:0030088): An elevated circulating testosterone level in the blood. Evidence: TAS. Frequency: Occasional (HP:0040283). (ORPHA:8)
- Encopresis (HP:0040183). Evidence: TAS. Frequency: Occasional (HP:0040283). (ORPHA:8)
These phenotypes are associated with the disease 47,XYY syndrome (ORPHA:8).